Phenotypes associated with the disease CADDS (ORPHA:369942):
- Global developmental delay (HP:0001263): A delay in the achievement of motor or mental milestones in the domains of development of a child, including motor skills, speech and language, cognitive skills, and social and emotional skills. This term should only be used to describe children younger than five years of age. Evidence: TAS. Frequency: Very frequent (HP:0040281). (ORPHA:369942)
- Cholestasis (HP:0001396): Impairment of bile flow due to obstruction in bile ducts. Evidence: TAS. Frequency: Very frequent (HP:0040281). (ORPHA:369942)
- Sensorineural hearing impairment (HP:0000407): A type of hearing impairment in one or both ears related to an abnormal functionality of the cochlear nerve. Evidence: TAS. Frequency: Frequent (HP:0040282). (ORPHA:369942)
- Seizure (HP:0001250): A seizure is an intermittent abnormality of nervous system physiology characterized by a transient occurrence of signs and/or symptoms due to abnormal excessive or synchronous neuronal activity in the brain. Evidence: TAS. Frequency: Frequent (HP:0040282). (ORPHA:369942)
- Intrauterine growth retardation (HP:0001511): An abnormal restriction of fetal growth with fetal weight below the tenth percentile for gestational age. Evidence: TAS. Frequency: Frequent (HP:0040282). (ORPHA:369942)
- Abnormal cerebral white matter morphology (HP:0002500): An abnormality of the cerebral white matter. Evidence: TAS. Frequency: Frequent (HP:0040282). (ORPHA:369942)
- Cholangitis (HP:0030151): Inflammation of the biliary ductal system, affecting the intrahepatic or extrahepatic portions, or both. Evidence: TAS. Frequency: Frequent (HP:0040282). (ORPHA:369942)
- Increased circulating very long-chain fatty acid concentration (HP:0033643): Increased concentration of very long-chain fatty acids in the blood circulation. Very long-chain fatty acids are fatty acids (FAs) with a chain-length of 22 or more carbons. Evidence: TAS. Frequency: Frequent (HP:0040282). (ORPHA:369942)
- Micrognathia (HP:0000347): Developmental hypoplasia of the mandible. Evidence: TAS. Frequency: Occasional (HP:0040283). (ORPHA:369942)
- Strabismus (HP:0000486): A misalignment of the eyes so that the visual axes deviate from bifoveal fixation. The classification of strabismus may be based on a number of features including the relative position of the eyes, whether the deviation is latent or manifest, intermittent or constant, concomitant or otherwise and according to the age of onset and the relevance of any associated refractive error. Evidence: TAS. Frequency: Occasional (HP:0040283). (ORPHA:369942)
- Cataract (HP:0000518): A cataract is an opacity or clouding that develops in the crystalline lens of the eye or in its capsule. Evidence: TAS. Frequency: Occasional (HP:0040283). (ORPHA:369942)
- Adrenal hypoplasia (HP:0000835): Developmental hypoplasia of the adrenal glands. Evidence: TAS. Frequency: Occasional (HP:0040283). (ORPHA:369942)
- Cerebellar atrophy (HP:0001272): Cerebellar atrophy is defined as a cerebellum with initially normal structures, in a posterior fossa with normal size, which displays enlarged fissures (interfolial spaces) in comparison to the foliae secondary to loss of tissue. Cerebellar atrophy implies irreversible loss of tissue and result from an ongoing progressive disease until a final stage is reached or a single injury, e.g. an intoxication or infectious event. Evidence: TAS. Frequency: Occasional (HP:0040283). (ORPHA:369942)
- Dystonia (HP:0001332): An abnormally increased muscular tone that causes fixed abnormal postures. There is a slow, intermittent twisting motion that leads to exaggerated turning and posture of the extremities and trunk. Evidence: TAS. Frequency: Occasional (HP:0040283). (ORPHA:369942)
- Ventriculomegaly (HP:0002119): An increase in size of the ventricular system of the brain. Evidence: TAS. Frequency: Occasional (HP:0040283). (ORPHA:369942)
- Elevated circulating hepatic transaminase concentration (HP:0002910): Elevations of the levels of SGOT and SGPT in the serum. SGOT (serum glutamic oxaloacetic transaminase) and SGPT (serum glutamic pyruvic transaminase) are transaminases primarily found in the liver and heart and are released into the bloodstream as the result of liver or heart damage. SGOT and SGPT are used clinically mainly as markers of liver damage. Evidence: TAS. Frequency: Occasional (HP:0040283). (ORPHA:369942)
- Short nose (HP:0003196): Distance from nasion to subnasale more than two standard deviations below the mean, or alternatively, an apparently decreased length from the nasal root to the nasal tip. Evidence: TAS. Frequency: Occasional (HP:0040283). (ORPHA:369942)